- Abnormal nail morphology (HP:0001597): Abnormal structure or appearance of the nail. Evidence: IEA. (OMIM:161100)
- Autosomal dominant inheritance (HP:0000006): A mode of inheritance that is observed for traits related to a gene encoded on one of the autosomes (i.e., the human chromosomes 1-22) in which a trait manifests in heterozygotes. In the context of medical genetics, an autosomal dominant disorder is caused when a single copy of the mutant allele is present. Males and females are affected equally, and can both transmit the disorder with a risk of 50% for each child of inheriting the mutant allele. Evidence: IEA. (OMIM:161100)
These phenotypes are associated with the disease NAILBEDS, PIGMENTATION OF (OMIM:161100).